- High-frequency hearing impairment (HP:0005101): A type of hearing impairment affecting primarily the higher frequencies of sound (3,000 to 6,000 Hz). Evidence: TAS. (OMIM:612644)
- Autosomal dominant inheritance (HP:0000006): A mode of inheritance that is observed for traits related to a gene encoded on one of the autosomes (i.e., the human chromosomes 1-22) in which a trait manifests in heterozygotes. In the context of medical genetics, an autosomal dominant disorder is caused when a single copy of the mutant allele is present. Males and females are affected equally, and can both transmit the disorder with a risk of 50% for each child of inheriting the mutant allele. Evidence: TAS. (OMIM:612644)
These phenotypes are associated with the disease autosomal dominant nonsyndromic hearing loss 2B (OMIM:612644).